Phenotypes associated with the disease Bardet-Biedl syndrome 9 (OMIM:615986):
- Astigmatism (HP:0000483): A type of refraction error associated with abnormal curvatures on the anterior and/or posterior surface of the cornea. Evidence: PCS. Frequency: 1/2. (PMID:26846096)
- Congenital onset (HP:0003577): A phenotypic abnormality that is present at birth. Evidence: PCS. Frequency: 2/2. (PMID:26846096)
- Spicular pigmentation of the retina (HP:0007737): Pigment migration into the retina in a bone-spicule configuration (resembling the nucleated cells within the lacuna of bone). Evidence: PCS. Frequency: 1/1. (PMID:34212515)
- Strabismus (HP:0000486): A misalignment of the eyes so that the visual axes deviate from bifoveal fixation. The classification of strabismus may be based on a number of features including the relative position of the eyes, whether the deviation is latent or manifest, intermittent or constant, concomitant or otherwise and according to the age of onset and the relevance of any associated refractive error. Evidence: PCS. Frequency: 1/2. (PMID:26846096)
- Brachydactyly (HP:0001156): Digits that appear disproportionately short compared to the hand/foot. The word brachydactyly is used here to describe a series distinct patterns of shortened digits (brachydactyly types A-E). This is the sense used here. Evidence: PCS. Frequency: 2/2. (PMID:26846096)
- Renal insufficiency (HP:0000083): A reduction in the level of performance of the kidneys in areas of function comprising the concentration of urine, removal of wastes, the maintenance of electrolyte balance, homeostasis of blood pressure, and calcium metabolism. Evidence: PCS. Frequency: 1/3. (PMID:22353939)
- Hyperglycemia (HP:0003074): An increased concentration of glucose in the blood. Evidence: PCS. Frequency: 1/1. (PMID:34212515)
- Polydactyly (HP:0010442): A congenital anomaly characterized by the presence of supernumerary fingers or toes. Evidence: PCS. Frequency: 1/3. (PMID:22353939)
- Cataract (HP:0000518): A cataract is an opacity or clouding that develops in the crystalline lens of the eye or in its capsule. Evidence: PCS. Frequency: 1/2. (PMID:26846096)
- Irregular menstruation (HP:0000858): Abnormally high variation in the amount of time between periods. Evidence: PCS. Frequency: 1/1. (PMID:26846096)
- Rod-cone dystrophy (HP:0000510): An inherited retinal disease subtype in which the rod photoreceptors appear to be more severely affected than the cone photoreceptors. Typical presentation is with nyctalopia (due to rod dysfunction) followed by loss of mid-peripheral field of vision, which gradually extends and leaves many patients with a small central island of vision due to the preservation of macular cones. Evidence: PCS. Frequency: 4/4. (PMID:22353939;PMID:34212515)
- Attenuation of retinal blood vessels (HP:0007843): Narrowing of the retinal blood vessels, both arterioles and venules. Evidence: PCS. Frequency: 1/1. (PMID:34212515)
- Intellectual disability (HP:0001249): The term intellectual disability or intellectual developmental disorder is used to describe significantly sub-average intellectual and adaptive functioning based on clinical assessment and as measured by individually administered, appropriately normed, standardized and validated tests of intellectual functioning and adaptive behavior, with onset during the developmental period from infancy through adolescence. Evidence: PCS. Frequency: 2/4. (PMID:22353939;PMID:34212515)
- Delayed speech and language development (HP:0000750): A degree of language development that is significantly below the norm for a child of a specified age. Evidence: PCS. Frequency: 2/2. (PMID:26846096)
- Postaxial hand polydactyly (HP:0001162): Supernumerary digits located at the ulnar side of the hand (that is, on the side with the fifth finger). Evidence: PCS. Frequency: 1/1. (PMID:34212515)
- Global developmental delay (HP:0001263): A delay in the achievement of motor or mental milestones in the domains of development of a child, including motor skills, speech and language, cognitive skills, and social and emotional skills. This term should only be used to describe children younger than five years of age. Evidence: PCS. Frequency: 2/2. (PMID:26846096)
- Polyphagia (HP:0002591): A neurological anomaly with gross overeating associated with an abnormally strong desire or need to eat. Evidence: PCS. Frequency: 1/1. (PMID:34212515)
- Postaxial polydactyly (HP:0100259): A form of polydactyly in which the extra digit or digits are localized on the side of the fifth finger or fifth toe. Evidence: PCS. Frequency: 2/2. (PMID:26846096)
- Polydipsia (HP:0001959): Excessive thirst manifested by excessive fluid intake. Evidence: PCS. Frequency: 1/1. (PMID:34212515)
- Autosomal recessive inheritance (HP:0000007): A mode of inheritance that is observed for traits related to a gene encoded on one of the autosomes (i.e., the human chromosomes 1-22) in which a trait manifests in individuals with two pathogenic alleles, either homozygotes (two copies of the same mutant allele) or compound heterozygotes (whereby each copy of a gene has a distinct mutant allele). Evidence: PCS. (PMID:16380913)
- Retinal degeneration (HP:0000546): A nonspecific term denoting progressive loss of the retinal pigment epithelium (RPE) and/or neurosensory retinal cells. Evidence: PCS. Frequency: 2/2. (PMID:26846096)
- Truncal obesity (HP:0001956): Obesity located preferentially in the trunk of the body as opposed to the extremities. Evidence: PCS. Frequency: 1/1. (PMID:34212515)
- Syndactyly (HP:0001159): Webbing or fusion of the fingers or toes, involving soft parts only or including bone structure. Bony fusions are referred to as "bony" syndactyly if the fusion occurs in a radio-ulnar axis. Fusions of bones of the fingers or toes in a proximo-distal axis are referred to as "symphalangism". Evidence: PCS. Frequency: 2/2. (PMID:26846096)
- Postaxial foot polydactyly (HP:0001830): Polydactyly of the foot most commonly refers to the presence of six toes on one foot. Postaxial polydactyly affects the lateral ray and the duplication may range from a well-formed articulated digit to a rudimentary digit. Evidence: PCS. Frequency: 1/1. (PMID:34212515)
- Obesity (HP:0001513): Accumulation of substantial excess body fat. Evidence: PCS. Frequency: 3/5. (PMID:26846096;PMID:22353939)